Phenotypes associated with the disease cleft palate-lateral synechia syndrome (OMIM:119550):
- Cleft palate (HP:0000175): Cleft palate is a developmental defect of the palate resulting from a failure of fusion of the palatine processes and manifesting as a separation of the roof of the mouth (soft and hard palate). Evidence: IEA. (OMIM:119550)
- Autosomal dominant inheritance (HP:0000006): A mode of inheritance that is observed for traits related to a gene encoded on one of the autosomes (i.e., the human chromosomes 1-22) in which a trait manifests in heterozygotes. In the context of medical genetics, an autosomal dominant disorder is caused when a single copy of the mutant allele is present. Males and females are affected equally, and can both transmit the disorder with a risk of 50% for each child of inheriting the mutant allele. Evidence: IEA. (OMIM:119550)